Phenotypes associated with the disease autism, susceptibility to, 8 (OMIM:607373):
- Delayed speech and language development (HP:0000750): A degree of language development that is significantly below the norm for a child of a specified age. Evidence: IEA. (OMIM:607373)
- EEG abnormality (HP:0002353): Abnormality observed by electroencephalogram (EEG), which is used to record of the brain's spontaneous electrical activity from multiple electrodes placed on the scalp. Evidence: IEA. Frequency: Frequent (HP:0040282). (OMIM:607373)
- Seizure (HP:0001250): A seizure is an intermittent abnormality of nervous system physiology characterized by a transient occurrence of signs and/or symptoms due to abnormal excessive or synchronous neuronal activity in the brain. Evidence: IEA. Frequency: Frequent (HP:0040282). (OMIM:607373)
- Increased serum serotonin (HP:0003144): A increased concentration of serotonin in the blood. Evidence: IEA. Frequency: Frequent (HP:0040282). (OMIM:607373)
- Childhood onset (HP:0011463): Onset of disease at the age of between 1 and 5 years. Evidence: IEA. (OMIM:607373)
- Autism (HP:0000717): Autism is a neurodevelopmental disorder characterized by impaired social interaction and communication, and by restricted and repetitive behavior. Autism begins in childhood. It is marked by the presence of markedly abnormal or impaired development in social interaction and communication and a markedly restricted repertoire of activity and interest. Manifestations of the disorder vary greatly depending on the developmental level and chronological age of the individual (DSM-IV). Evidence: TAS. (OMIM:607373)
- Reduced ability to form peer relationships (HP:0000728): Difficulty to establish relations with others in a comparable social group (peers) that may be manifested in pehnomena such as not being able to initiative a conversation, understand social cues, or to discuss shared interests. This feature is associated with poor integration within a community or group. Evidence: IEA. (OMIM:607373)
- Restrictive behavior (HP:0000723): Behavior characterized by an abnormal limitation to a few interests and activities. Evidence: TAS. (OMIM:607373)
- Motor stereotypy (HP:0000733): Use of the same abnormal action in response to certain triggers or at random. They may be used as a way to regulate one's internal state but must otherwise have no apparent functional purpose. Evidence: TAS. (OMIM:607373)
- Non-Mendelian inheritance (HP:0001426): A mode of inheritance that depends on genetic determinants in more than one gene. Evidence: IEA. (OMIM:607373)
- Abnormal nonverbal communicative behavior (HP:0000758): Abnormalities in eye contact, communicative facial expressions, gesture use, or the use of others' bodies to communicate convey shared meanings within a culture that replace or supplement verbal communication. Evidence: IEA. (OMIM:607373)
- Sporadic (HP:0003745): Cases of the disease in question occur without a previous family history, i.e., as isolated cases without being transmitted from a parent and without other siblings being affected. Evidence: IEA. (OMIM:607373)
- Lack of spontaneous play (HP:0000721). Evidence: IEA. (OMIM:607373)
- Inflexible adherence to routines (HP:0000732): A need to strictly adhere to repetitive routines or patterns of behavior which are created by the environment. One becomes upset or distressed when their routines are disrupted or altered. Evidence: IEA. (OMIM:607373)
- Intellectual disability (HP:0001249): The term intellectual disability or intellectual developmental disorder is used to describe significantly sub-average intellectual and adaptive functioning based on clinical assessment and as measured by individually administered, appropriately normed, standardized and validated tests of intellectual functioning and adaptive behavior, with onset during the developmental period from infancy through adolescence. Evidence: IEA. (OMIM:607373)